- Strabismus (HP:0000486): A misalignment of the eyes so that the visual axes deviate from bifoveal fixation. The classification of strabismus may be based on a number of features including the relative position of the eyes, whether the deviation is latent or manifest, intermittent or constant, concomitant or otherwise and according to the age of onset and the relevance of any associated refractive error. Evidence: TAS. Frequency: Very frequent (HP:0040281). (ORPHA:1313)
- Seizure (HP:0001250): A seizure is an intermittent abnormality of nervous system physiology characterized by a transient occurrence of signs and/or symptoms due to abnormal excessive or synchronous neuronal activity in the brain. Evidence: TAS. Frequency: Very frequent (HP:0040281). (ORPHA:1313)
- Hyperreflexia (HP:0001347): Hyperreflexia is the presence of hyperactive stretch reflexes of the muscles. Evidence: TAS. Frequency: Very frequent (HP:0040281). (ORPHA:1313)
- Cerebral calcification (HP:0002514): The presence of calcium deposition within the cerebrum. Evidence: TAS. Frequency: Very frequent (HP:0040281). (ORPHA:1313)
- Severe intellectual disability (HP:0010864): Severe intellectual disability (ID) is defined as a type of ID characterized by severely sub-average adaptive functioning and intellectual functioning, with an intelligence quotient (IQ) the range of 20-34. Evidence: TAS. Frequency: Very frequent (HP:0040281). (ORPHA:1313)
These phenotypes are associated with the disease Infantile choroidocerebral calcification syndrome (ORPHA:1313).